- Delayed ability to roll over (HP:0032989): Delayed achievement of the ability to roll front to back and back to front. Evidence: PCS. Frequency: 1/1. (PMID:29648665)
- Lateral ventricle dilatation (HP:0006956). Evidence: PCS. Frequency: 1/1. (PMID:29648665)
- Tented upper lip vermilion (HP:0010804): Triangular appearance of the oral aperture with the apex in the midpoint of the upper vermilion and the lower vermilion forming the base. Evidence: PCS. Frequency: 1/1. (PMID:29648665)
- Long philtrum (HP:0000343): Distance between nasal base and midline upper lip vermilion border more than 2 SD above the mean. Alternatively, an apparently increased distance between nasal base and midline upper lip vermilion border. Evidence: PCS. Frequency: 1/1. (PMID:29648665)
- Delayed speech and language development (HP:0000750): A degree of language development that is significantly below the norm for a child of a specified age. Evidence: PCS. Frequency: 1/1. (PMID:29648665)
- Talipes equinovarus (HP:0001762): Talipes equinovarus (also called clubfoot) typically has four main components: inversion and adduction of the forefoot; inversion of the heel and hindfoot; equinus (limitation of extension) of the ankle and subtalar joint; and internal rotation of the leg. Evidence: PCS. Frequency: 1/1. (PMID:29648665)
- Global developmental delay (HP:0001263): A delay in the achievement of motor or mental milestones in the domains of development of a child, including motor skills, speech and language, cognitive skills, and social and emotional skills. This term should only be used to describe children younger than five years of age. Evidence: PCS. Frequency: 1/1. (PMID:29648665)
- Infantile onset (HP:0003593): Onset of signs or symptoms of disease between 28 days to one year of life. Evidence: PCS. Frequency: 1/1. (PMID:29648665)
- Progressive spasticity (HP:0002191): Spasticity that increases in degree with time. Evidence: PCS. Frequency: 1/1. (PMID:29648665)
- Severe global developmental delay (HP:0011344): A severe delay in the achievement of motor or mental milestones in the domains of development of a child. Evidence: PCS. Frequency: 1/1. (PMID:29648665)
- Small posterior fossa (HP:0040010). Evidence: PCS. Frequency: 1/1. (PMID:29648665)
- Ptosis (HP:0000508): The upper eyelid margin is positioned 3 mm or more lower than usual and covers the superior portion of the iris (objective); or, the upper lid margin obscures at least part of the pupil (subjective). Evidence: PCS. Frequency: 1/1. (PMID:29648665)
- Autosomal recessive inheritance (HP:0000007): A mode of inheritance that is observed for traits related to a gene encoded on one of the autosomes (i.e., the human chromosomes 1-22) in which a trait manifests in individuals with two pathogenic alleles, either homozygotes (two copies of the same mutant allele) or compound heterozygotes (whereby each copy of a gene has a distinct mutant allele). Evidence: PCS. (PMID:29648665)
- Short corpus callosum (HP:0200012). Evidence: PCS. Frequency: 1/1. (PMID:29648665)
- Delayed ability to sit (HP:0025336): A failure to achieve the ability to sit at an appropriate developmental stage. Most children sit with support at 6 months of age and sit steadily without support at 9 months of age. Evidence: PCS. Frequency: 1/1. (PMID:29648665)
- Intellectual disability (HP:0001249): The term intellectual disability or intellectual developmental disorder is used to describe significantly sub-average intellectual and adaptive functioning based on clinical assessment and as measured by individually administered, appropriately normed, standardized and validated tests of intellectual functioning and adaptive behavior, with onset during the developmental period from infancy through adolescence. Evidence: PCS. Frequency: 1/1. (PMID:29648665)
- Brachycephaly (HP:0000248): An abnormality of skull shape characterized by a decreased anterior-posterior diameter. That is, a cephalic index greater than 81%. Alternatively, an apparently shortened anteroposterior dimension (length) of the head compared to width. Evidence: PCS. Frequency: 1/1. (PMID:29648665)
These phenotypes are associated with the disease neurodevelopmental disorder with severe motor impairment, absent language, cerebral hypomyelination, and brain atrophy (OMIM:619972).